Phenotypes associated with the disease Congenital alveolar capillary dysplasia (ORPHA:210122):
- Hydronephrosis (HP:0000126): Severe distention of the kidney with dilation of the renal pelvis and calices. Evidence: TAS. Frequency: Occasional (HP:0040283). (ORPHA:210122)
- Single umbilical artery (HP:0001195): Single umbilical artery (SUA) is the absence of one of the two umbilical arteries surrounding the fetal bladder and in the fetal umbilical cord. Evidence: TAS. Frequency: Occasional (HP:0040283). (ORPHA:210122)
- Ventricular septal defect (HP:0001629): A hole between the two bottom chambers (ventricles) of the heart. The defect is centered around the most superior aspect of the ventricular septum. Evidence: TAS. Frequency: Occasional (HP:0040283). (ORPHA:210122)
- Atrial septal defect (HP:0001631): Atrial septal defect (ASD) is a congenital abnormality of the interatrial septum that enables blood flow between the left and right atria via the interatrial septum. Evidence: TAS. Frequency: Occasional (HP:0040283). (ORPHA:210122)
- Tetralogy of Fallot (HP:0001636): A congenital cardiac malformation comprising pulmonary stenosis, overriding aorta, ventricular septum defect, and right ventricular hypertrophy. The diagnosis of TOF is made if at least three of the four above mentioned features are present. Evidence: TAS. Frequency: Occasional (HP:0040283). (ORPHA:210122)
- Patent ductus arteriosus (HP:0001643): In utero, the ductus arteriosus (DA) serves to divert ventricular output away from the lungs and toward the placenta by connecting the main pulmonary artery to the descending aorta. A patent ductus arteriosus (PDA) in the first 3 days of life is a physiologic shunt in healthy term and preterm newborn infants, and normally is substantially closed within about 24 hours after bith and completely closed after about three weeks. Failure of physiologcal closure is referred to a persistent or patent ductus arteriosus (PDA). Depending on the degree of left-to-right shunting, PDA can have clinical consequences. Evidence: TAS. Frequency: Frequent (HP:0040282). (ORPHA:210122)
- Bicuspid aortic valve (HP:0001647): The presence of an aortic valve with two instead of the normal three cusps (flaps). Bicuspid aortic valvue is a malformation of a commissure (small space between the attachment of each cusp to the aortic wall) and the adjacent parts of the two corresponding cusps forming a raphe (the fused area of the two underdeveloped cusps turning into a malformed commissure between both cusps; the raphe is a fibrous ridge that extends from the commissure to the free edge of the two underdeveloped, conjoint cusps). Evidence: TAS. Frequency: Occasional (HP:0040283). (ORPHA:210122)
- Aortic valve stenosis (HP:0001650): The presence of a stenosis (narrowing) of the aortic valve. Evidence: TAS. Frequency: Occasional (HP:0040283). (ORPHA:210122)
- Annular pancreas (HP:0001734): A congenital anomaly in which the pancreas completely (or sometimes incompletely) encircles the second portion of duodenum and occasionally obstructs the more proximal duodenum. Evidence: TAS. Frequency: Occasional (HP:0040283). (ORPHA:210122)
- Asplenia (HP:0001746): Absence (aplasia) of the spleen. Evidence: TAS. Frequency: Occasional (HP:0040283). (ORPHA:210122)
- Anal atresia (HP:0002023): Congenital absence of the anus, i.e., the opening at the bottom end of the intestinal tract. Evidence: TAS. Frequency: Occasional (HP:0040283). (ORPHA:210122)
- Pulmonary arterial hypertension (HP:0002092): Pulmonary hypertension is defined mean pulmonary artery pressure of 25mmHg or more and pulmonary capillary wedge pressure of 15mmHg or less when measured by right heart catheterisation at rest and in a supine position. Evidence: TAS. Frequency: Very frequent (HP:0040281). (ORPHA:210122)
- Respiratory distress (HP:0002098): Respiratory distress is objectively observable as the physical or emotional consequences from the experience of dyspnea. The physical presentation of respiratory distress is generally referred to as labored breathing, while the sensation of respiratory distress is called shortness of breath or dyspnea. Evidence: TAS. Frequency: Very frequent (HP:0040281). (ORPHA:210122)
- Aganglionic megacolon (HP:0002251): An abnormality resulting from a lack of intestinal ganglion cells (i.e., an aganglionic section of bowel) that results in bowel obstruction with enlargement of the colon. Evidence: TAS. Frequency: Occasional (HP:0040283). (ORPHA:210122)
- Intestinal malrotation (HP:0002566): An abnormality of the intestinal rotation and fixation that normally occurs during the development of the gut. This can lead to volvulus, or twisting of the intestine that causes obstruction and necrosis. Evidence: TAS. Frequency: Frequent (HP:0040282). (ORPHA:210122)
- Tracheoesophageal fistula (HP:0002575): An abnormal connection (fistula) between the esophagus and the trachea. Evidence: TAS. Frequency: Occasional (HP:0040283). (ORPHA:210122)
- Volvulus (HP:0002580): Abnormal twisting of a portion of intestine around itself or around a stalk of mesentery tissue. Evidence: TAS. Frequency: Occasional (HP:0040283). (ORPHA:210122)
- Abnormal vertebral morphology (HP:0003468): An abnormality of one or more of the vertebrae. Evidence: TAS. Frequency: Occasional (HP:0040283). (ORPHA:210122)
- Hypoplastic left ventricle (HP:0004383): A severe congenital heart defect characterized by underdevelopment of the left ventricle. Evidence: TAS. Frequency: Frequent (HP:0040282). (ORPHA:210122)
- Atrioventricular canal defect (HP:0006695): A defect of the atrioventricular septum of the heart. Evidence: TAS. Frequency: Occasional (HP:0040283). (ORPHA:210122)
- Pulmonary valve atresia (HP:0010882): A congenital disorder of the pulmonary valve in which the orifice of the valve fails to develop. Evidence: TAS. Frequency: Occasional (HP:0040283). (ORPHA:210122)
- Absent gallbladder (HP:0011467): A developmental defect in which the gallbladder fails to form. Evidence: TAS. Frequency: Occasional (HP:0040283). (ORPHA:210122)
- Duodenal stenosis (HP:0100867): The narrowing or partial blockage of a portion of the duodenum. Evidence: TAS. Frequency: Occasional (HP:0040283). (ORPHA:210122)